Phenotypes associated with the disease toes, space between first and second (OMIM:189230):
- Sandal gap (HP:0001852): A widely spaced gap between the first toe (the great toe) and the second toe. Evidence: IEA. (OMIM:189230)
- Autosomal dominant inheritance (HP:0000006): A mode of inheritance that is observed for traits related to a gene encoded on one of the autosomes (i.e., the human chromosomes 1-22) in which a trait manifests in heterozygotes. In the context of medical genetics, an autosomal dominant disorder is caused when a single copy of the mutant allele is present. Males and females are affected equally, and can both transmit the disorder with a risk of 50% for each child of inheriting the mutant allele. Evidence: IEA. (OMIM:189230)